- Abnormality of the endocrine system (HP:0000818): An abnormality of the endocrine system. Evidence: IEA. (OMIM:171200)
- Autosomal dominant inheritance (HP:0000006): A mode of inheritance that is observed for traits related to a gene encoded on one of the autosomes (i.e., the human chromosomes 1-22) in which a trait manifests in heterozygotes. In the context of medical genetics, an autosomal dominant disorder is caused when a single copy of the mutant allele is present. Males and females are affected equally, and can both transmit the disorder with a risk of 50% for each child of inheriting the mutant allele. Evidence: IEA. (OMIM:171200)
These phenotypes are associated with the disease THIOUREA TASTINGPHENYLTHIOCARBAMIDE TASTING, INCLUDED (OMIM:171200).